- Muscle weakness (HP:0001324): Reduced strength of muscles. Evidence: TAS. Frequency: Very frequent (HP:0040281). (ORPHA:81)
- Respiratory insufficiency (HP:0002093). Evidence: TAS. Frequency: Very frequent (HP:0040281). (ORPHA:81)
- Pulmonary fibrosis (HP:0002206): Replacement of normal lung tissues by fibroblasts and collagen. Evidence: TAS. Frequency: Very frequent (HP:0040281). (ORPHA:81)
- Autoimmunity (HP:0002960): The occurrence of an immune reaction against the organism's own cells or tissues. Evidence: TAS. Frequency: Very frequent (HP:0040281). (ORPHA:81)
- Myalgia (HP:0003326): Pain in muscle. Evidence: TAS. Frequency: Very frequent (HP:0040281). (ORPHA:81)
- Abnormal pulmonary interstitial morphology (HP:0006530): Abnormality of the lung parenchyma extending to the pulmonary interstitium and leading to diffuse pulmonary fibrosis. Evidence: TAS. Frequency: Very frequent (HP:0040281). (ORPHA:81)
- Cough (HP:0012735): A sudden, audible expulsion of air from the lungs through a partially closed glottis, preceded by inhalation. Evidence: TAS. Frequency: Very frequent (HP:0040281). (ORPHA:81)
- Myositis (HP:0100614): A general term for inflammation of the muscles without respect to the underlying cause. Evidence: TAS. Frequency: Very frequent (HP:0040281). (ORPHA:81)
- Chest pain (HP:0100749): An unpleasant sensation characterized by physical discomfort (such as pricking, throbbing, or aching) localized to the chest. Evidence: TAS. Frequency: Very frequent (HP:0040281). (ORPHA:81)
- Xerostomia (HP:0000217): Dryness of the mouth due to salivary gland dysfunction. Evidence: TAS. Frequency: Frequent (HP:0040282). (ORPHA:81)
- Edema (HP:0000969): An abnormal accumulation of fluid beneath the skin, or in one or more cavities of the body. Evidence: TAS. Frequency: Frequent (HP:0040282). (ORPHA:81)
- Keratoconjunctivitis sicca (HP:0001097): Dryness of the eye related to deficiency of the tear film components (aqueous, mucin, or lipid), lid surface abnormalities, or epithelial abnormalities. Keratoconjunctivitis sicca often results in a scratchy or sandy sensation (foreign body sensation) in the eyes, and may also be associated with itching, inability to produce tears, photosensitivity, redness, pain, and difficulty in moving the eyelids. Evidence: TAS. Frequency: Frequent (HP:0040282). (ORPHA:81)
- Hypotonia (HP:0001252): Hypotonia is an abnormally low muscle tone (the amount of tension or resistance to movement in a muscle). Even when relaxed, muscles have a continuous and passive partial contraction which provides some resistance to passive stretching. Hypotonia thus manifests as diminished resistance to passive stretching. Hypotonia is not the same as muscle weakness, although the two conditions can co-exist. Evidence: TAS. Frequency: Frequent (HP:0040282). (ORPHA:81)
- Arthritis (HP:0001369): Inflammation of a joint. Evidence: TAS. Frequency: Frequent (HP:0040282). (ORPHA:81)
- Fever (HP:0001945): Body temperature elevated above the normal range. Evidence: TAS. Frequency: Frequent (HP:0040282). (ORPHA:81)
- Dyspnea (HP:0002094): Difficult or labored breathing. Dyspnea is a subjective feeling only the patient can rate, e.g., on a Borg scale. Evidence: TAS. Frequency: Frequent (HP:0040282). (ORPHA:81)
- Arthralgia (HP:0002829): Joint pain. Evidence: TAS. Frequency: Frequent (HP:0040282). (ORPHA:81)
- Elevated circulating creatine kinase activity (HP:0003236): The activity of creatine kinase in the blood circulation is above the upper limit of normal. Evidence: TAS. Frequency: Frequent (HP:0040282). (ORPHA:81)
- EMG abnormality (HP:0003457): Abnormal results of investigations using electromyography (EMG). Evidence: TAS. Frequency: Frequent (HP:0040282). (ORPHA:81)
- Raynaud phenomenon (HP:0030880). Evidence: TAS. Frequency: Frequent (HP:0040282). (ORPHA:81)
- Anti-threonyl-tRNA synthetase antibody positivity (HP:0034143): The presence of autoantibodies (immunoglobulins) in the blood circulation that react against threonyl-tRNA synthetase. Evidence: TAS. Frequency: Frequent (HP:0040282). (ORPHA:81)
- Anti-alanyl-tRNA synthetase antibody positivity (HP:0034145): The presence of autoantibodies (immunoglobulins) in the blood circulation that react against alanyl-tRNA synthetase. Evidence: TAS. Frequency: Frequent (HP:0040282). (ORPHA:81)
- Anti-glycyl tRNA-synthetase antibody positivity (HP:0034146): The presence of autoantibodies (immunoglobulins) in the blood circulation that react against glycyl tRNA-synthetase. Evidence: TAS. Frequency: Frequent (HP:0040282). (ORPHA:81)
- Anti-aminoacyl-tRNA synthetase antibody positivity (HP:0034147): The presence of autoantibodies (immunoglobulins) in the blood circulation that react against a tRNA synthetase enzyme. Evidence: TAS. Frequency: Frequent (HP:0040282). (ORPHA:81)
- Anti-isoleucyl tRNA-synthetase antibody positivity (HP:0034148): The presence of autoantibodies (immunoglobulins) in the blood circulation that react against isoleucyl tRNA-synthetase. Evidence: TAS. Frequency: Frequent (HP:0040282). (ORPHA:81)
- Anti-phenylalanyl tRNA synthetase antibody positivity (HP:0034149): The presence of autoantibodies (immunoglobulins) in the blood circulation that react against phenylalanyl tRNA synthetase. Evidence: TAS. Frequency: Frequent (HP:0040282). (ORPHA:81)
- Anti-tyrosyl-tRNA synthetase antibody positivity (HP:0034150): The presence of autoantibodies (immunoglobulins) in the blood circulation that react against tyrosyl-tRNA synthetase. Evidence: TAS. Frequency: Frequent (HP:0040282). (ORPHA:81)
- Anti-asparaginyl-tRNA synthetase antibody positivity (HP:0034151): The presence of autoantibodies (immunoglobulins) in the blood circulation that react against asparaginyl-tRNA synthetase. Evidence: TAS. Frequency: Frequent (HP:0040282). (ORPHA:81)
- Anti-histidyl tRNA synthetase antibody positivity (HP:0034152): The presence of autoantibodies (immunoglobulins) in the blood circulation that react against histidyl tRNA synthetase. Evidence: TAS. Frequency: Frequent (HP:0040282). (ORPHA:81)
- Anti-cytosolic-5-nucleotidase-1A antibody positivity (HP:0034153): The presence of autoantibodies (immunoglobulins) in the blood circulation that react against cytosolic-5-nucleotidase-1A (cN1A). Evidence: TAS. Frequency: Frequent (HP:0040282). (ORPHA:81)
- Lack of skin elasticity (HP:0100679). Evidence: TAS. Frequency: Frequent (HP:0040282). (ORPHA:81)
- Skin rash (HP:0000988): A red eruption of the skin. Evidence: TAS. Frequency: Occasional (HP:0040283). (ORPHA:81)
- Pruritus (HP:0000989): Pruritus is an itch or a sensation that makes a person want to scratch. This term refers to an abnormally increased disposition to experience pruritus. Evidence: TAS. Frequency: Occasional (HP:0040283). (ORPHA:81)
- Joint dislocation (HP:0001373): Displacement or malalignment of joints. Evidence: TAS. Frequency: Occasional (HP:0040283). (ORPHA:81)
- Abnormality of the voice (HP:0001608). Evidence: TAS. Frequency: Occasional (HP:0040283). (ORPHA:81)
- Aortic regurgitation (HP:0001659): An insufficiency of the aortic valve, leading to regurgitation (backward flow) of blood from the aorta into the left ventricle. Evidence: TAS. Frequency: Occasional (HP:0040283). (ORPHA:81)
- Dysphagia (HP:0002015): Difficulty in swallowing. Evidence: TAS. Frequency: Occasional (HP:0040283). (ORPHA:81)
- Pulmonary arterial hypertension (HP:0002092): Pulmonary hypertension is defined mean pulmonary artery pressure of 25mmHg or more and pulmonary capillary wedge pressure of 15mmHg or less when measured by right heart catheterisation at rest and in a supine position. Evidence: TAS. Frequency: Occasional (HP:0040283). (ORPHA:81)
- Recurrent respiratory infections (HP:0002205): An increased susceptibility to respiratory infections as manifested by a history of recurrent respiratory infections. Evidence: TAS. Frequency: Occasional (HP:0040283). (ORPHA:81)
- Neoplasm (HP:0002664): An organ or organ-system abnormality that consists of uncontrolled autonomous cell-proliferation which can occur in any part of the body as a benign or malignant neoplasm (tumor). Evidence: TAS. Frequency: Occasional (HP:0040283). (ORPHA:81)
- Myocarditis (HP:0012819): Inflammation of the myocardium. Evidence: TAS. Frequency: Occasional (HP:0040283). (ORPHA:81)
- Telangiectasia of the skin (HP:0100585): Presence of small, permanently dilated blood vessels near the surface of the skin, visible as small focal red lesions. Evidence: TAS. Frequency: Occasional (HP:0040283). (ORPHA:81)
- Mechanic's hands (HP:6001013): Mechanic's hands are fissured, erythematous, hyperkeratotic eruptions on the hands, resembling the type of occupational dermatosis said to resemble the hands of a manual laborer. The lesions are classically on the lateral edges of the fingers and thumbs, largely sparing the palmar, and dorsal aspects of the digits. Evidence: TAS. Frequency: Occasional (HP:0040283). (ORPHA:81)
- Hiker's feet (HP:6001014): Hyperkeratotic scaly fissured plaques on the fingers/palms or soles, generally more evident on the lateral aspect of index fingers. Evidence: TAS. Frequency: Occasional (HP:0040283). (ORPHA:81)
These phenotypes are associated with the disease Antisynthetase syndrome (ORPHA:81).